Phenotypes associated with the disease neurodevelopmental disorder with dysmorphic facies, absent speech and ambulation, and brain abnormalities (OMIM:621012):
- Encephalopathy (HP:0001298): Encephalopathy is a term that means brain disease, damage, or malfunction. In general, encephalopathy is manifested by an altered mental state. Evidence: PCS. Frequency: 1/1. (PMID:39442041)
- Bilateral tonic-clonic seizure (HP:0002069): A bilateral tonic-clonic seizure is a seizure defined by a tonic (bilateral increased tone, lasting seconds to minutes) and then a clonic (bilateral sustained rhythmic jerking) phase. Evidence: PCS. Frequency: 0/2. (PMID:39442041)
- Increased body weight (HP:0004324): Abnormally increased body weight. Evidence: PCS. Frequency: 1/1. (PMID:39442041)
- Dystonia (HP:0001332): An abnormally increased muscular tone that causes fixed abnormal postures. There is a slow, intermittent twisting motion that leads to exaggerated turning and posture of the extremities and trunk. Evidence: PCS. Frequency: 1/1. (PMID:39442041)
- Seizure (HP:0001250): A seizure is an intermittent abnormality of nervous system physiology characterized by a transient occurrence of signs and/or symptoms due to abnormal excessive or synchronous neuronal activity in the brain. Evidence: PCS. Frequency: 0/1. (PMID:39442041)
- Generalized hypotonia (HP:0001290): Generalized muscular hypotonia (abnormally low muscle tone). Evidence: PCS. Frequency: 1/1. (PMID:39442041)
- Myoclonic seizure (HP:0032794): A myoclonic seizure is a type of motor seizure characterized by sudden, brief (<100 ms) involuntary single or multiple contraction of muscles or muscle groups of variable topography (axial, proximal limb, distal). Myoclonus is less regularly repetitive and less sustained than is clonus. Evidence: PCS. Frequency: 1/2. (PMID:39442041)
- Thin corpus callosum (HP:0033725): An abnormally thin corpus callous, due to atrophy, hypoplasia or agenesis. This term is intended to be used in situations where it is not known if thinning of the corpus callosum (for instance, as visualized by magnetic resonance tomography) is due to abnormal development (e.g. a leukodystrophy) or atrophy following normal development (e.g. neurodegeneration). Evidence: PCS. Frequency: 3/3. (PMID:39442041)
- Infantile spasms (HP:0012469): Infantile spasms represent a subset of "epileptic spasms". Infantile Spasms are epileptic spasms starting in the first year of life (infancy). Evidence: PCS. Frequency: 2/2. (PMID:39442041)
- Hypertrichosis (HP:0000998): Hypertrichosis is increased hair growth that is abnormal in quantity or location. Evidence: PCS. Frequency: 1/1. (PMID:39442041)
- Hypertelorism (HP:0000316): Interpupillary distance more than 2 SD above the mean (alternatively, the appearance of an increased interpupillary distance or widely spaced eyes). Evidence: PCS. Frequency: 2/2. (PMID:39442041)
- Proximal placement of thumb (HP:0009623): Proximal mislocalization of the thumb. Evidence: PCS. Frequency: 1/1. (PMID:39442041)
- CNS hypomyelination (HP:0003429): Reduced amount of myelin in the central nervous system resulting from defective myelinogenesis. Evidence: PCS. Frequency: 3/3. (PMID:39442041)
- Neonatal onset (HP:0003623): Onset of signs or symptoms of disease within the first 28 days of life. Evidence: PCS. Frequency: 3/3. (PMID:39442041)
- EEG abnormality (HP:0002353): Abnormality observed by electroencephalogram (EEG), which is used to record of the brain's spontaneous electrical activity from multiple electrodes placed on the scalp. Evidence: PCS. Frequency: 1/2. (PMID:39442041)
- Congenital posterior urethral valve (HP:0010957): A developmental defect resulting in an obstructing membrane in the posterior male urethra. Evidence: PCS. Frequency: 1/1. (PMID:39442041)
- Thick eyebrow (HP:0000574): Increased density/number and/or increased diameter of eyebrow hairs. Evidence: PCS. Frequency: 1/1. (PMID:39442041)
- Feeding difficulties (HP:0011968): Impaired ability to eat related to problems gathering food and getting ready to suck, chew, or swallow it. Evidence: PCS. Frequency: 2/2. (PMID:39442041)
- Delayed ability to walk with support (HP:0033257): A failure to achieve the ability to walk with support (cruise) at an appropriate developmental stage. Evidence: PCS. Frequency: 3/3. (PMID:39442041)
- Adducted thumb (HP:0001181): In the resting position, the tip of the thumb is on, or near, the palm, close to the base of the fourth or fifth finger. Evidence: PCS. Frequency: 1/1. (PMID:39442041)
- Optic nerve hypoplasia (HP:0000609): Underdevelopment of the optic nerve. Evidence: PCS. Frequency: 1/1. (PMID:39442041)
- Exocrine pancreatic insufficiency (HP:0001738): Impaired function of the exocrine pancreas associated with a reduced ability to digest foods because of lack of digestive enzymes. Evidence: PCS. Frequency: 1/1. (PMID:39442041)
- Hyperbilirubinemia (HP:0002904): An increased amount of bilirubin in the blood. Evidence: PCS. Frequency: 1/1. (PMID:39442041)
- Limb hypertonia (HP:0002509). Evidence: PCS. Frequency: 1/1. (PMID:39442041)
- Optic atrophy (HP:0000648): Atrophy of the optic nerve. Optic atrophy results from the death of the retinal ganglion cell axons that comprise the optic nerve and manifesting as a pale optic nerve on fundoscopy. Evidence: PCS. Frequency: 3/3. (PMID:39442041)
- Low-set ears (HP:0000369): Upper insertion of the ear to the scalp below an imaginary horizontal line drawn between the inner canthi of the eye and extending posteriorly to the ear. Evidence: PCS. Frequency: 1/1. (PMID:39442041)
- Autosomal dominant inheritance (HP:0000006): A mode of inheritance that is observed for traits related to a gene encoded on one of the autosomes (i.e., the human chromosomes 1-22) in which a trait manifests in heterozygotes. In the context of medical genetics, an autosomal dominant disorder is caused when a single copy of the mutant allele is present. Males and females are affected equally, and can both transmit the disorder with a risk of 50% for each child of inheriting the mutant allele. Evidence: PCS. (PMID:39442041)
- Chronic diarrhea (HP:0002028): The presence of chronic diarrhea, which is usually taken to mean diarrhea that has persisted for over 4 weeks. Evidence: PCS. Frequency: 1/1. (PMID:39442041)
- Hypsarrhythmia (HP:0002521): Hypsarrhythmia is abnormal interictal high amplitude waves and a background of irregular spikes. There is continuous (during wakefulness), high-amplitude (>200 Hz), generalized polymorphic slowing with no organized background and multifocal spikes demonstrated by electroencephalography (EEG). Evidence: PCS. Frequency: 1/1. (PMID:39442041)
- Upslanted palpebral fissure (HP:0000582): The palpebral fissure inclination is more than two standard deviations above the mean for age (objective); or, the inclination of the palpebral fissure is greater than typical for age. Evidence: PCS. Frequency: 1/1. (PMID:39442041)
- Long philtrum (HP:0000343): Distance between nasal base and midline upper lip vermilion border more than 2 SD above the mean. Alternatively, an apparently increased distance between nasal base and midline upper lip vermilion border. Evidence: PCS. Frequency: 2/2. (PMID:39442041)
- Anteverted nares (HP:0000463): Anteriorly-facing nostrils viewed with the head in the Frankfurt horizontal and the eyes of the observer level with the eyes of the subject. This gives the appearance of an upturned nose (upturned nasal tip). Evidence: PCS. Frequency: 2/2. (PMID:39442041)
- Cerebral cortical atrophy (HP:0002120): Atrophy of the cortex of the cerebrum. Evidence: PCS. Frequency: 3/3. (PMID:39442041)
- Severe intellectual disability (HP:0010864): Severe intellectual disability (ID) is defined as a type of ID characterized by severely sub-average adaptive functioning and intellectual functioning, with an intelligence quotient (IQ) the range of 20-34. Evidence: PCS. Frequency: 3/3. (PMID:39442041)
- Pyelonephritis (HP:0012330): An inflammation of the kidney involving the parenchyma of kidney, the renal pelvis and the kidney calices. Evidence: PCS. Frequency: 1/1. (PMID:39442041)
- Failure to thrive (HP:0001508): Failure to thrive (FTT) refers to a child whose physical growth is substantially below the norm. Evidence: PCS. Frequency: 1/1. (PMID:39442041)
- Ventriculomegaly (HP:0002119): An increase in size of the ventricular system of the brain. Evidence: PCS. Frequency: 1/1. (PMID:39442041)
- Axial hypotonia (HP:0008936): Muscular hypotonia (abnormally low muscle tone) affecting the musculature of the trunk. Evidence: PCS. Frequency: 1/1. (PMID:39442041)
- Polyhydramnios (HP:0001561): The presence of excess amniotic fluid in the uterus during pregnancy. Evidence: PCS. Frequency: 1/1. (PMID:39442041)
- Vesicoureteral reflux (HP:0000076): Abnormal (retrograde) movement of urine from the bladder into ureters or kidneys related to inadequacy of the valvular mechanism at the ureterovesicular junction or other causes. Evidence: PCS. Frequency: 2/3. (PMID:39442041)
- Delayed speech and language development (HP:0000750): A degree of language development that is significantly below the norm for a child of a specified age. Evidence: PCS. Frequency: 3/3. (PMID:39442041)
- Distal arthrogryposis (HP:0005684): An inherited primary limb malformation disorder characterized by congenital contractures of two or more different body areas and without primary neurologic and/or muscle disease that affects limb function. Evidence: PCS. Frequency: 1/1. (PMID:39442041)
- Secondary microcephaly (HP:0005484): Head circumference which falls below 2 standard deviations below the mean for age and gender because of insufficient head growth after birth. Evidence: PCS. Frequency: 1/2. (PMID:39442041)
- Severe global developmental delay (HP:0011344): A severe delay in the achievement of motor or mental milestones in the domains of development of a child. Evidence: PCS. Frequency: 3/3. (PMID:39442041)
- Tonic seizure (HP:0032792): A tonic seizure is a type of motor seizure characterized by unilateral or bilateral limb stiffening or elevation, often with neck stiffening. Evidence: PCS. Frequency: 1/2. (PMID:39442041)
- Atrial septal defect (HP:0001631): Atrial septal defect (ASD) is a congenital abnormality of the interatrial septum that enables blood flow between the left and right atria via the interatrial septum. Evidence: PCS. Frequency: 1/1. (PMID:39442041)
- Cryptorchidism (HP:0000028): Testis in inguinal canal. That is, absence of one or both testes from the scrotum owing to failure of the testis or testes to descend through the inguinal canal to the scrotum. Evidence: PCS. Frequency: 1/1. (PMID:39442041)
- Micrognathia (HP:0000347): Developmental hypoplasia of the mandible. Evidence: PCS. Frequency: 1/1. (PMID:39442041)
- Neonatal respiratory distress (HP:0002643): Respiratory difficulty as newborn. Evidence: PCS. Frequency: 1/1. (PMID:39442041)